Phenotypes associated with the disease Leber congenital amaurosis 13 (OMIM:612712):
- Spicular pigmentation of the retina (HP:0007737): Pigment migration into the retina in a bone-spicule configuration (resembling the nucleated cells within the lacuna of bone). Evidence: PCS. (PMID:15258582)
- Childhood onset (HP:0011463): Onset of disease at the age of between 1 and 5 years. Evidence: PCS. (PMID:15258582)
- Autosomal recessive inheritance (HP:0000007): A mode of inheritance that is observed for traits related to a gene encoded on one of the autosomes (i.e., the human chromosomes 1-22) in which a trait manifests in individuals with two pathogenic alleles, either homozygotes (two copies of the same mutant allele) or compound heterozygotes (whereby each copy of a gene has a distinct mutant allele). Evidence: PCS. (PMID:15258582)
- Reduced visual acuity (HP:0007663). Evidence: PCS. (PMID:15258582)
- Optic disc pallor (HP:0000543): A pale yellow discoloration of the optic disc (the area of the optic nerve head in the retina). The optic disc normally has a pinkish hue with a central yellowish depression. Evidence: PCS. (PMID:15258582)
- Attenuation of retinal blood vessels (HP:0007843): Narrowing of the retinal blood vessels, both arterioles and venules. Evidence: PCS. (PMID:15258582)
- Retinal dystrophy (HP:0000556): Retinal dystrophy is an abnormality of the retina associated with a hereditary process. Retinal dystrophies are defined by their predominantly monogenic inheritance and they are frequently associated with loss or dysfunction of photoreceptor cells as a primary or secondary event. Evidence: PCS. (PMID:15258582)
- Autosomal dominant inheritance (HP:0000006): A mode of inheritance that is observed for traits related to a gene encoded on one of the autosomes (i.e., the human chromosomes 1-22) in which a trait manifests in heterozygotes. In the context of medical genetics, an autosomal dominant disorder is caused when a single copy of the mutant allele is present. Males and females are affected equally, and can both transmit the disorder with a risk of 50% for each child of inheriting the mutant allele. Evidence: TAS. (OMIM:612712)